Phenotypes associated with the disease Ayme-Gripp syndrome (OMIM:601088):
- Abnormality of the dentition (HP:0000164): Any abnormality of the teeth. Evidence: PCS. Frequency: 6/15. (PMID:30160832)
- Upslanted palpebral fissure (HP:0000582): The palpebral fissure inclination is more than two standard deviations above the mean for age (objective); or, the inclination of the palpebral fissure is greater than typical for age. Evidence: TAS. Frequency: Occasional (HP:0040283). (OMIM:601088)
- Long philtrum (HP:0000343): Distance between nasal base and midline upper lip vermilion border more than 2 SD above the mean. Alternatively, an apparently increased distance between nasal base and midline upper lip vermilion border. Evidence: PCS. Frequency: 11/15. (PMID:30160832)
- Hearing impairment (HP:0000365): A decreased magnitude of the sensory perception of sound. Evidence: PCS. Frequency: 15/15. (PMID:30160832)
- Brachydactyly (HP:0001156): Digits that appear disproportionately short compared to the hand/foot. The word brachydactyly is used here to describe a series distinct patterns of shortened digits (brachydactyly types A-E). This is the sense used here. Evidence: PCS. Frequency: 12/15. (PMID:30160832)
- Short stature (HP:0004322): A height below that which is expected according to age and gender norms. Although there is no universally accepted definition of short stature, many refer to "short stature" as height more than 2 standard deviations below the mean for age and gender (or below the 3rd percentile for age and gender dependent norms). Evidence: IEA. Onset: Infantile onset (HP:0003593). (OMIM:601088)
- Seizure (HP:0001250): A seizure is an intermittent abnormality of nervous system physiology characterized by a transient occurrence of signs and/or symptoms due to abnormal excessive or synchronous neuronal activity in the brain. Evidence: PCS. Frequency: 8/10. (PMID:30160832)
- Narrow mouth (HP:0000160): Distance between the commissures of the mouth more than 2 SD below the mean. Alternatively, an apparently decreased width of the oral aperture (subjective). Evidence: PCS. Frequency: 10/15. (PMID:30160832)
- Craniofacial asymmetry (HP:0004484): Asymmetry of the bones of the skull and the face. Evidence: TAS. Frequency: Occasional (HP:0040283). (OMIM:601088)
- Short nose (HP:0003196): Distance from nasion to subnasale more than two standard deviations below the mean, or alternatively, an apparently decreased length from the nasal root to the nasal tip. Evidence: PCS. Frequency: 13/15. (PMID:30160832)
- Flat face (HP:0012368): Absence of concavity or convexity of the face when viewed in profile. Evidence: TAS. (OMIM:601088)
- Smooth philtrum (HP:0000319): Flat skin surface, with no ridge formation in the central region of the upper lip between the nasal base and upper vermilion border. Evidence: TAS. (OMIM:601088)
- Developmental cataract (HP:0000519): A cataract that occurs congenitally as the result of a developmental defect, in contrast to the majority of cataracts that occur in adulthood as the result of degenerative changes of the lens. Evidence: PCS. Frequency: 14/15. (PMID:30160832)
- Microtia (HP:0008551): Underdevelopment of the external ear. Evidence: TAS. Frequency: Occasional (HP:0040283). (OMIM:601088)
- Hypertelorism (HP:0000316): Interpupillary distance more than 2 SD above the mean (alternatively, the appearance of an increased interpupillary distance or widely spaced eyes). Evidence: PCS. Frequency: 9/15. (PMID:30160832)
- Pericarditis (HP:0001701): Inflammation of the sac-like covering around the heart (pericardium). Evidence: PCS. Frequency: 6/15. (PMID:30160832)
- Thin upper lip vermilion (HP:0000219): Height of the vermilion of the upper lip in the midline more than 2 SD below the mean. Alternatively, an apparently reduced height of the vermilion of the upper lip in the frontal view (subjective). Evidence: PCS. Frequency: 10/15. (PMID:30160832)
- Intellectual disability (HP:0001249): The term intellectual disability or intellectual developmental disorder is used to describe significantly sub-average intellectual and adaptive functioning based on clinical assessment and as measured by individually administered, appropriately normed, standardized and validated tests of intellectual functioning and adaptive behavior, with onset during the developmental period from infancy through adolescence. Evidence: PCS. Frequency: 15/15. (PMID:30160832)
- Posteriorly rotated ears (HP:0000358): A type of abnormal location of the ears in which the position of the ears is characterized by posterior rotation (the superior part of the ears is rotated towards the back of the head, and the inferior part of the ears towards the front). Evidence: TAS. Frequency: Occasional (HP:0040283). (OMIM:601088)
- Radioulnar synostosis (HP:0002974): An abnormal osseous union (fusion) between the radius and the ulna. Evidence: IEA. (OMIM:601088)
- Cerebral atrophy (HP:0002059): Atrophy (wasting, decrease in size of cells or tissue) affecting the cerebrum. Evidence: TAS. Frequency: Occasional (HP:0040283). (OMIM:601088)
- Downslanted palpebral fissures (HP:0000494): The palpebral fissure inclination is more than two standard deviations below the mean. Evidence: TAS. Frequency: Occasional (HP:0040283). (OMIM:601088)
- Wide nasal bridge (HP:0000431): Increased breadth of the nasal bridge (and with it, the nasal root). Evidence: TAS. (OMIM:601088)
- Delayed cranial suture closure (HP:0000270): Infants normally have two fontanels at birth, the diamond-shaped anterior fontanelle at the junction of the coronal and sagittal sutures, and the posterior fontanelle at the intersection of the occipital and parietal bones. The posterior fontanelle usually closes by the 8th week of life, and the anterior fontanel closes by the 18th month of life on average. This term applies if there is delay of closure of the fontanelles beyond the normal age. Evidence: TAS. Frequency: Occasional (HP:0040283). (OMIM:601088)
- Malar flattening (HP:0000272): Underdevelopment of the malar prominence of the jugal bone (zygomatic bone in mammals), appreciated in profile, frontal view, and/or by palpation. Evidence: IEA. (OMIM:601088)
- Midface retrusion (HP:0011800): Posterior positions and/or vertical shortening of the infraorbital and perialar regions, or increased concavity of the face and/or reduced nasolabial angle. Evidence: PCS. Frequency: 15/15. (PMID:30160832)
- Tapered finger (HP:0001182): The gradual reduction in girth of the finger from proximal to distal. Evidence: TAS. Frequency: Occasional (HP:0040283). (OMIM:601088)
- Broad eyebrow (HP:0011229): Regional increase in the width (height) of the eyebrow. Evidence: PCS. Frequency: 8/15. (PMID:30160832)
- Depressed nasal bridge (HP:0005280): Posterior positioning of the nasal root in relation to the overall facial profile for age. Evidence: PCS. Frequency: 11/15. (PMID:30160832)
- Camptodactyly (HP:0012385): The distal interphalangeal joint and/or the proximal interphalangeal joint of the fingers or toes cannot be extended to 180 degrees by either active or passive extension. Evidence: PCS. Frequency: Occasional (HP:0040283). (PMID:30160832)
- Sensorineural hearing impairment (HP:0000407): A type of hearing impairment in one or both ears related to an abnormal functionality of the cochlear nerve. Evidence: IEA. (OMIM:601088)
- Chiari type I malformation (HP:0007099): Arnold-Chiari type I malformation refers to a relatively mild degree of herniation of the posteroinferior region of the cerebellum (the cerebellar tonsils) into the cervical canal with little or no displacement of the fourth ventricle. It is characterized by one or both pointed (not rounded) cerebellar tonsils that project 5 mm below the foramen magnum, measured by a line drawn from the basion to the opisthion (McRae Line). Evidence: TAS. Frequency: Occasional (HP:0040283). (OMIM:601088)
- Ptosis (HP:0000508): The upper eyelid margin is positioned 3 mm or more lower than usual and covers the superior portion of the iris (objective); or, the upper lid margin obscures at least part of the pupil (subjective). Evidence: TAS. (OMIM:601088)
- Sparse scalp hair (HP:0002209): Decreased number of hairs per unit area of skin of the scalp. Evidence: TAS. Frequency: Occasional (HP:0040283). (OMIM:601088)
- Pectus excavatum (HP:0000767): A defect of the chest wall characterized by a depression of the sternum, giving the chest ("pectus") a caved-in ("excavatum") appearance. Evidence: PCS. Frequency: 3/15. (PMID:30160832)
- High forehead (HP:0000348): An abnormally increased height of the forehead. Evidence: PCS. Frequency: 11/15. (PMID:30160832)
- Nail dystrophy (HP:0008404): Onychodystrophy (nail dystrophy) refers to nail changes apart from changes of the color (nail dyschromia) and involves partial or complete disruption of the various keratinous layers of the nail plate. Evidence: TAS. Frequency: Occasional (HP:0040283). (OMIM:601088)
- Broad philtrum (HP:0000289): Distance between the philtral ridges, measured just above the vermilion border, more than 2 standard deviations above the mean, or alternatively, an apparently increased distance between the ridges of the philtrum. Evidence: TAS. (OMIM:601088)
- Autosomal dominant inheritance (HP:0000006): A mode of inheritance that is observed for traits related to a gene encoded on one of the autosomes (i.e., the human chromosomes 1-22) in which a trait manifests in heterozygotes. In the context of medical genetics, an autosomal dominant disorder is caused when a single copy of the mutant allele is present. Males and females are affected equally, and can both transmit the disorder with a risk of 50% for each child of inheriting the mutant allele. Evidence: PCS. (PMID:30160832)
- Low-set ears (HP:0000369): Upper insertion of the ear to the scalp below an imaginary horizontal line drawn between the inner canthi of the eye and extending posteriorly to the ear. Evidence: TAS. (OMIM:601088)
- Mandibular prognathia (HP:0000303): Abnormal prominence of the chin related to increased length of the mandible. Evidence: TAS. Frequency: Occasional (HP:0040283). (OMIM:601088)
- Brachycephaly (HP:0000248): An abnormality of skull shape characterized by a decreased anterior-posterior diameter. That is, a cephalic index greater than 81%. Alternatively, an apparently shortened anteroposterior dimension (length) of the head compared to width. Evidence: IEA. (OMIM:601088)